- Abnormality of the bladder (HP:0000014): An abnormality of the urinary bladder. Evidence: TAS. Frequency: Occasional (HP:0040283). (ORPHA:247604)
- Sensory neuropathy (HP:0000763): Peripheral neuropathy affecting the sensory nerves. Evidence: TAS. Frequency: Occasional (HP:0040283). (ORPHA:247604)
- Spasticity (HP:0001257): A motor disorder characterized by a velocity-dependent increase in tonic stretch reflexes with increased muscle tone, exaggerated (hyperexcitable) tendon reflexes. Evidence: TAS. Frequency: Very frequent (HP:0040281). (ORPHA:247604)
- Spastic tetraparesis (HP:0001285): Spastic weakness affecting all four limbs. Evidence: TAS. Frequency: Very frequent (HP:0040281). (ORPHA:247604)
- Muscle weakness (HP:0001324): Reduced strength of muscles. Evidence: TAS. Frequency: Very frequent (HP:0040281). (ORPHA:247604)
- Hyperreflexia (HP:0001347): Hyperreflexia is the presence of hyperactive stretch reflexes of the muscles. Evidence: TAS. Frequency: Very frequent (HP:0040281). (ORPHA:247604)
- Dysphagia (HP:0002015): Difficulty in swallowing. Evidence: TAS. Frequency: Frequent (HP:0040282). (ORPHA:247604)
- Spastic gait (HP:0002064): Spasticity is manifested by increased stretch reflex which is intensified with movement velocity. This results in excessive and inappropriate muscle activation which can contribute to muscle hypertonia. Spastic gait is characterized by manifestations such as muscle hypertonia, stiff knee, and circumduction of the leg. Evidence: TAS. Frequency: Very frequent (HP:0040281). (ORPHA:247604)
- Abnormal upper motor neuron morphology (HP:0002127): Any structural anomaly that affects the upper motor neuron. Evidence: TAS. Frequency: Very frequent (HP:0040281). (ORPHA:247604)
- Gait imbalance (HP:0002141). Evidence: TAS. Frequency: Very frequent (HP:0040281). (ORPHA:247604)
- Pseudobulbar affect (HP:0002193): Pseudobulbar affect (PBA) is characterized by uncontrolled crying or laughing which may be disproportionate or inappropriate to the social context. Thus, there is a disparity between the patient's emotional expression and his or her emotional experience. Evidence: TAS. Frequency: Very frequent (HP:0040281). (ORPHA:247604)
- Loss of speech (HP:0002371). Evidence: TAS. Frequency: Frequent (HP:0040282). (ORPHA:247604)
- Spastic dysarthria (HP:0002464): A type of dysarthria related to bilateral damage of the upper motor neuron tracts of the pyramidal and extra- pyramidal tracts. Speech of affected individuals is slow, effortful, and has a harsh vocal quality. Evidence: TAS. Frequency: Frequent (HP:0040282). (ORPHA:247604)
- Skeletal muscle atrophy (HP:0003202): The presence of skeletal muscular atrophy (which is also known as amyotrophy). Evidence: TAS. Frequency: Occasional (HP:0040283). (ORPHA:247604)
- Abnormal pyramidal sign (HP:0007256): Functional neurological abnormalities related to dysfunction of the pyramidal tract. Evidence: TAS. Frequency: Very frequent (HP:0040281). (ORPHA:247604)
These phenotypes are associated with the disease Juvenile primary lateral sclerosis (ORPHA:247604).